Phenotypes associated with the disease Blood group, cromer system (OMIM:613793):
- Protein-losing enteropathy (HP:0002243): Abnormal loss of protein from the digestive tract related to excessive leakage of plasma proteins into the lumen of the gastrointestinal tract. Evidence: IEA. Frequency: Very rare (HP:0040284). (OMIM:613793)
- Autosomal recessive inheritance (HP:0000007): A mode of inheritance that is observed for traits related to a gene encoded on one of the autosomes (i.e., the human chromosomes 1-22) in which a trait manifests in individuals with two pathogenic alleles, either homozygotes (two copies of the same mutant allele) or compound heterozygotes (whereby each copy of a gene has a distinct mutant allele). Evidence: IEA. (OMIM:613793)